- Alopecia universalis (HP:0002289): Loss of all hair on the entire body. Evidence: IEA. (OMIM:610422)
- Autosomal recessive inheritance (HP:0000007): A mode of inheritance that is observed for traits related to a gene encoded on one of the autosomes (i.e., the human chromosomes 1-22) in which a trait manifests in individuals with two pathogenic alleles, either homozygotes (two copies of the same mutant allele) or compound heterozygotes (whereby each copy of a gene has a distinct mutant allele). Evidence: IEA. (OMIM:610422)
- Intellectual disability (HP:0001249): The term intellectual disability or intellectual developmental disorder is used to describe significantly sub-average intellectual and adaptive functioning based on clinical assessment and as measured by individually administered, appropriately normed, standardized and validated tests of intellectual functioning and adaptive behavior, with onset during the developmental period from infancy through adolescence. Evidence: IEA. (OMIM:610422)
These phenotypes are associated with the disease alopecia-intellectual disability syndrome 2 (OMIM:610422).